- Diabetes mellitus (HP:0000819): A group of abnormalities characterized by hyperglycemia and glucose intolerance. Evidence: IEA. (OMIM:601942)
This phenotype is associated with the disease type 1 diabetes mellitus 10 (OMIM:601942).